- Gonadal neoplasm (HP:0010785): A tumor (abnormal growth of tissue) of a gonad. Evidence: TAS. Frequency: Frequent (HP:0040282). (ORPHA:180229)
- Neuroectodermal neoplasm (HP:0030061): A neoplasm arising in the neuroectoderm, the portion of the ectoderm of the early embryo that gives rise to the central and peripheral nervous systems, including some glial cells. Evidence: TAS. Frequency: Frequent (HP:0040282). (ORPHA:180229)
- Abnormal circulating gonadotropin concentration (HP:0030338): An anomaly of the circulating level of a gonadotropin, that is, of a protein hormone secreted by gonadotrope cells of the anterior pituitary of vertebrates. The primary gonadotropins are luteinizing hormone (LH) and follicle-stimulating hormone (FSH). Evidence: TAS. Frequency: Frequent (HP:0040282). (ORPHA:180229)
- Abdominal pain (HP:0002027): An unpleasant sensation characterized by physical discomfort (such as pricking, throbbing, or aching) and perceived to originate in the abdomen. Evidence: TAS. Frequency: Occasional (HP:0040283). (ORPHA:180229)
- Abnormal peritoneum morphology (HP:0002585): An abnormality of the peritoneum. Evidence: TAS. Frequency: Occasional (HP:0040283). (ORPHA:180229)
- Abnormal sacrum morphology (HP:0005107): An abnormality of the sacral bone. Evidence: TAS. Frequency: Occasional (HP:0040283). (ORPHA:180229)
- Elevated circulating alpha-fetoprotein concentration (HP:0006254): The concentration of alpha-fetoprotein in the blood circulation is above the upper limit of normal. Evidence: TAS. Frequency: Occasional (HP:0040283). (ORPHA:180229)
- Neoplasm of head and neck (HP:0012288): A tumor (abnormal growth of tissue) of the head and neck region with origin in the lip, oral cavity, nasal cavity, paranasal sinuses, pharynx, or larynx. Evidence: TAS. Frequency: Occasional (HP:0040283). (ORPHA:180229)
- Abdominal mass (HP:0031500): An abnormal enlargement or swelling in the abdomen. Evidence: TAS. Frequency: Occasional (HP:0040283). (ORPHA:180229)
- Abnormal onset of bleeding (HP:0040231). Evidence: TAS. Frequency: Occasional (HP:0040283). (ORPHA:180229)
- Abnormal mediastinum morphology (HP:0045026): Any structural anomaly of the central compartment of the thoracic cavity. Evidence: TAS. Frequency: Occasional (HP:0040283). (ORPHA:180229)
- Macroorchidism (HP:0000053): The presence of abnormally large testes. Evidence: TAS. Frequency: Very rare (HP:0040284). (ORPHA:180229)
- Abnormality of the endocrine system (HP:0000818): An abnormality of the endocrine system. Evidence: TAS. Frequency: Very rare (HP:0040284). (ORPHA:180229)
- Irregular menstruation (HP:0000858): Abnormally high variation in the amount of time between periods. Evidence: TAS. Frequency: Very rare (HP:0040284). (ORPHA:180229)
- Fever (HP:0001945): Body temperature elevated above the normal range. Evidence: TAS. Frequency: Very rare (HP:0040284). (ORPHA:180229)
- Increased serum serotonin (HP:0003144): A increased concentration of serotonin in the blood. Evidence: TAS. Frequency: Very rare (HP:0040284). (ORPHA:180229)
- Abdominal distention (HP:0003270): Distention of the abdomen. Evidence: TAS. Frequency: Very rare (HP:0040284). (ORPHA:180229)
- Isosexual precocious puberty (HP:0008236). Evidence: TAS. Frequency: Very rare (HP:0040284). (ORPHA:180229)
- Increased serum testosterone level (HP:0030088): An elevated circulating testosterone level in the blood. Evidence: TAS. Frequency: Very rare (HP:0040284). (ORPHA:180229)
These phenotypes are associated with the disease Polyembryoma (ORPHA:180229).